- Cryptorchidism (HP:0000028): Testis in inguinal canal. That is, absence of one or both testes from the scrotum owing to failure of the testis or testes to descend through the inguinal canal to the scrotum. Evidence: TAS. Frequency: Occasional (HP:0040283). (ORPHA:2077)
- Ambiguous genitalia (HP:0000062): A genital phenotype that is not clearly assignable to a single gender. Ambiguous genitalia can be evaluated using the Prader scale: Prader 0: Normal female external genitalia. Prader 1: Female external genitalia with clitoromegaly. Prader 2: Clitoromegaly with partial labial fusion forming a funnel-shaped urogenital sinus. Prader 3: Increased phallic enlargement. Complete labioscrotal fusion forming a urogenital sinus with a single opening. Prader 4: Complete scrotal fusion with urogenital opening at the base or on the shaft of the phallus. Prader 5: Normal male external genitalia. The diagnosis of ambiguous genitalia is made for Prader 1-4. Evidence: TAS. Frequency: Occasional (HP:0040283). (ORPHA:2077)
- Open mouth (HP:0000194): A facial appearance characterized by a permanently or nearly permanently opened mouth. Evidence: TAS. Frequency: Very frequent (HP:0040281). (ORPHA:2077)
- Orofacial cleft (HP:0000202): The presence of a cleft (gap, opening, or groove) in the oral cavity, including cleft of the upper lip and/or cleft of the palate. Cleft of the upper lip is visible as a groove or fissure in the lip, most frequently due to a congenital failure of the maxillary and median nasal processes to fuse. Cleft palate is characterized by a grooved depression or fissure in the roof of the mouth, most often resulting from a congenital failure of the palate to fuse properly. Clefts of the lip and palate can occur individually or together. It is preferable to code each defect separately. Evidence: TAS. Frequency: Frequent (HP:0040282). (ORPHA:2077)
- High palate (HP:0000218): Height of the palate more than 2 SD above the mean (objective) or palatal height at the level of the first permanent molar more than twice the height of the teeth (subjective). Evidence: TAS. Frequency: Frequent (HP:0040282). (ORPHA:2077)
- Everted lower lip vermilion (HP:0000232): An abnormal configuration of the lower lip such that it is turned outward i.e., everted, with the Inner aspect of the lower lip vermilion (normally opposing the teeth) being visible in a frontal view. Evidence: TAS. Frequency: Very frequent (HP:0040281). (ORPHA:2077)
- Brachycephaly (HP:0000248): An abnormality of skull shape characterized by a decreased anterior-posterior diameter. That is, a cephalic index greater than 81%. Alternatively, an apparently shortened anteroposterior dimension (length) of the head compared to width. Evidence: TAS. Frequency: Very frequent (HP:0040281). (ORPHA:2077)
- Dolichocephaly (HP:0000268): An abnormality of skull shape characterized by a increased anterior-posterior diameter, i.e., an increased antero-posterior dimension of the skull. Cephalic index less than 76%. Alternatively, an apparently increased antero-posterior length of the head compared to width. Often due to premature closure of the sagittal suture. Evidence: TAS. Frequency: Very frequent (HP:0040281). (ORPHA:2077)
- Micrognathia (HP:0000347): Developmental hypoplasia of the mandible. Evidence: TAS. Frequency: Very frequent (HP:0040281). (ORPHA:2077)
- High forehead (HP:0000348): An abnormally increased height of the forehead. Evidence: TAS. Frequency: Very frequent (HP:0040281). (ORPHA:2077)
- Hearing abnormality (HP:0000364): An abnormality of the sensory perception of sound. Evidence: TAS. Frequency: Frequent (HP:0040282). (ORPHA:2077)
- Wide nasal bridge (HP:0000431): Increased breadth of the nasal bridge (and with it, the nasal root). Evidence: TAS. Frequency: Very frequent (HP:0040281). (ORPHA:2077)
- Short neck (HP:0000470): Diminished length of the neck. Evidence: TAS. Frequency: Frequent (HP:0040282). (ORPHA:2077)
- Strabismus (HP:0000486): A misalignment of the eyes so that the visual axes deviate from bifoveal fixation. The classification of strabismus may be based on a number of features including the relative position of the eyes, whether the deviation is latent or manifest, intermittent or constant, concomitant or otherwise and according to the age of onset and the relevance of any associated refractive error. Evidence: TAS. Frequency: Very frequent (HP:0040281). (ORPHA:2077)
- Downslanted palpebral fissures (HP:0000494): The palpebral fissure inclination is more than two standard deviations below the mean. Evidence: TAS. Frequency: Occasional (HP:0040283). (ORPHA:2077)
- Abnormal eyebrow morphology (HP:0000534): An abnormality of the eyebrow. Evidence: TAS. Frequency: Very frequent (HP:0040281). (ORPHA:2077)
- Synophrys (HP:0000664): Meeting of the medial eyebrows in the midline. Evidence: TAS. Frequency: Frequent (HP:0040282). (ORPHA:2077)
- Lymphedema (HP:0001004): Localized fluid retention and tissue swelling caused by a compromised lymphatic system. Evidence: TAS. Frequency: Very frequent (HP:0040281). (ORPHA:2077)
- Intellectual disability (HP:0001249): The term intellectual disability or intellectual developmental disorder is used to describe significantly sub-average intellectual and adaptive functioning based on clinical assessment and as measured by individually administered, appropriately normed, standardized and validated tests of intellectual functioning and adaptive behavior, with onset during the developmental period from infancy through adolescence. Evidence: TAS. Frequency: Very frequent (HP:0040281). (ORPHA:2077)
- Hypotonia (HP:0001252): Hypotonia is an abnormally low muscle tone (the amount of tension or resistance to movement in a muscle). Even when relaxed, muscles have a continuous and passive partial contraction which provides some resistance to passive stretching. Hypotonia thus manifests as diminished resistance to passive stretching. Hypotonia is not the same as muscle weakness, although the two conditions can co-exist. Evidence: TAS. Frequency: Very frequent (HP:0040281). (ORPHA:2077)
- Global developmental delay (HP:0001263): A delay in the achievement of motor or mental milestones in the domains of development of a child, including motor skills, speech and language, cognitive skills, and social and emotional skills. This term should only be used to describe children younger than five years of age. Evidence: TAS. Frequency: Very frequent (HP:0040281). (ORPHA:2077)
- Limitation of joint mobility (HP:0001376): A reduction in the freedom of movement of one or more joints. Evidence: TAS. Frequency: Very frequent (HP:0040281). (ORPHA:2077)
- Tetralogy of Fallot (HP:0001636): A congenital cardiac malformation comprising pulmonary stenosis, overriding aorta, ventricular septum defect, and right ventricular hypertrophy. The diagnosis of TOF is made if at least three of the four above mentioned features are present. Evidence: TAS. Frequency: Occasional (HP:0040283). (ORPHA:2077)
- Abnormal cardiac septum morphology (HP:0001671): An anomaly of the intra-atrial or intraventricular septum. Evidence: TAS. Frequency: Occasional (HP:0040283). (ORPHA:2077)
- Dysphagia (HP:0002015): Difficulty in swallowing. Evidence: TAS. Frequency: Very frequent (HP:0040281). (ORPHA:2077)
- Abnormal speech pattern (HP:0002167): An abnormality in the sound (volume) or cadence (rate) of speech. Evidence: TAS. Frequency: Very frequent (HP:0040281). (ORPHA:2077)
- Hypokinesia (HP:0002375): Abnormally diminished motor activity. In contrast to paralysis, hypokinesia is not characterized by a lack of motor strength, but rather by a poverty of movement. The typical habitual movements (e.g., folding the arms, crossing the legs) are reduced in frequency. Evidence: TAS. Frequency: Very frequent (HP:0040281). (ORPHA:2077)
- Arthrogryposis multiplex congenita (HP:0002804): Multiple congenital contractures in different body areas. Evidence: TAS. Frequency: Very frequent (HP:0040281). (ORPHA:2077)
- Short stature (HP:0004322): A height below that which is expected according to age and gender norms. Although there is no universally accepted definition of short stature, many refer to "short stature" as height more than 2 standard deviations below the mean for age and gender (or below the 3rd percentile for age and gender dependent norms). Evidence: TAS. Frequency: Very frequent (HP:0040281). (ORPHA:2077)
- Depressed nasal bridge (HP:0005280): Posterior positioning of the nasal root in relation to the overall facial profile for age. Evidence: TAS. Frequency: Very frequent (HP:0040281). (ORPHA:2077)
- Midface retrusion (HP:0011800): Posterior positions and/or vertical shortening of the infraorbital and perialar regions, or increased concavity of the face and/or reduced nasolabial angle. Evidence: TAS. Frequency: Very frequent (HP:0040281). (ORPHA:2077)
- Camptodactyly of finger (HP:0100490): The distal interphalangeal joint and/or the proximal interphalangeal joint of the fingers cannot be extended to 180 degrees by either active or passive extension. Evidence: TAS. Frequency: Frequent (HP:0040282). (ORPHA:2077)
These phenotypes are associated with the disease German syndrome (ORPHA:2077).